- Stage 5 chronic kidney disease (HP:0003774): A degree of kidney failure severe enough to require dialysis or kidney transplantation for survival characterized by a severe reduction in glomerular filtration rate (less than 15 ml/min/1.73 m2) and other manifestations including increased serum creatinine. Evidence: PCS. Frequency: 7/9. (PMID:11729243)
- Juvenile onset (HP:0003621): Onset of signs or symptoms of disease between the age of 5 and 15 years. Evidence: IEA. Frequency: 2/9. (OMIM:600995)
- Nephrotic syndrome (HP:0000100): Nephrotic syndrome is a collection of findings resulting from glomerular dysfunction with an increase in glomerular capillary wall permeability associated with pronounced proteinuria. Nephrotic syndrome refers to the constellation of clinical findings that result from severe renal loss of protein, with Proteinuria and hypoalbuminemia, edema, and hyperlipidemia. Evidence: PCS. Frequency: 9/9. (PMID:11729243)
- Edema (HP:0000969): An abnormal accumulation of fluid beneath the skin, or in one or more cavities of the body. Evidence: IEA. (OMIM:600995)
- Hyperlipidemia (HP:0003077): An elevated lipid concentration in the blood. Evidence: IEA. (OMIM:600995)
- Childhood onset (HP:0011463): Onset of disease at the age of between 1 and 5 years. Evidence: PCS. Frequency: 7/9. (PMID:11729243)
- Focal segmental glomerulosclerosis (HP:0000097): Segmental accumulation of scar tissue in individual (but not all) glomeruli. Evidence: PCS. (PMID:11729243)
- Hypoalbuminemia (HP:0003073): The concentration of albumin in the blood circulation is below the lower limit of normal. Evidence: IEA. (OMIM:600995)
- Autosomal recessive inheritance (HP:0000007): A mode of inheritance that is observed for traits related to a gene encoded on one of the autosomes (i.e., the human chromosomes 1-22) in which a trait manifests in individuals with two pathogenic alleles, either homozygotes (two copies of the same mutant allele) or compound heterozygotes (whereby each copy of a gene has a distinct mutant allele). Evidence: PCS. (PMID:10742096)
- Proteinuria (HP:0000093): Increased levels of protein in the urine. Evidence: PCS. Frequency: 9/9. (PMID:11729243)
- Rapidly progressive (HP:0003678): Applies to a disease manifestation that quickly increases in scope or severity over the course of time. Evidence: PCS. (PMID:11729243)
These phenotypes are associated with the disease nephrotic syndrome, type 2 (OMIM:600995).